- Dyspnea (HP:0002094): Difficult or labored breathing. Dyspnea is a subjective feeling only the patient can rate, e.g., on a Borg scale. Evidence: TAS. Frequency: Very frequent (HP:0040281). (ORPHA:79126)
- Bronchiectasis (HP:0002110): Persistent abnormal dilatation of the bronchi owing to localized and irreversible destruction and widening of the large airways. Evidence: TAS. Frequency: Very frequent (HP:0040281). (ORPHA:79126)
- Pulmonary infiltrates (HP:0002113). Evidence: TAS. Frequency: Very frequent (HP:0040281). (ORPHA:79126)
- Respiratory failure (HP:0002878): A severe form of respiratory insufficiency characterized by inadequate gas exchange such that the levels of oxygen or carbon dioxide cannot be maintained within normal limits. Evidence: TAS. Frequency: Very frequent (HP:0040281). (ORPHA:79126)
- Hypoxemia (HP:0012418): An abnormally low level of blood oxygen. Evidence: TAS. Frequency: Very frequent (HP:0040281). (ORPHA:79126)
- Peribronchovascular interstitial thickening (HP:0025177): Thickening of the peribronchovascular interstitium, a connective tissue sheath that surrounds the central bronchi and pulmonary arteries. The peribronchovascular interstitium extends from the level of the pulmonary hila into the peripheral lung. This feature may be ascertained on high-resolution computer tomography. Evidence: TAS. Frequency: Very frequent (HP:0040281). (ORPHA:79126)
- Ground-glass opacification (HP:0025179): On chest radiographs, ground-glass opacity appears as an area of hazy increased lung opacity, usually extensive, within which margins of pulmonary vessels may be indistinct. On CT scans, it appears as hazy increased opacity of lung, with preservation of bronchial and vascular margins. It is caused by partial filling of airspaces, interstitial thickening (due to fluid, cells, and/or fibrosis), partial collapse of alveoli, increased capillary blood volume, or a combination of these, the common factor being the partial displacement of air. Ground-glass opacity is less opaque than consolidation, in which bronchovascular margins are obscured. Evidence: TAS. Frequency: Very frequent (HP:0040281). (ORPHA:79126)
- Nodular pattern on pulmonary HRCT (HP:0025392): A nodular pattern is characterized on pulmonary high-resolution computed tomography by the presence of numerous rounded opacities that range from 2 mm to 1 cm in diameter, with micronodules defined as smaller than 3 mm in diameter. Evidence: TAS. Frequency: Very frequent (HP:0040281). (ORPHA:79126)
- Reticulonodular pattern on pulmonary HRCT (HP:0025393): Co-occurrence of reticular and micronodular patterns on pulmonary high-resolution computed tomography. Evidence: TAS. Frequency: Very frequent (HP:0040281). (ORPHA:79126)
- Interlobular septal thickening (HP:0030879): Presence of thickening of the interlobular septa of the lungs as seen on a CT scan. Evidence: TAS. Frequency: Very frequent (HP:0040281). (ORPHA:79126)
- Parenchymal consolidation (HP:0032177): Consolidation refers to an exudate or other product of disease that replaces alveolar air, rendering the lung solid (as in infective pneumonia). Evidence: TAS. Frequency: Very frequent (HP:0040281). (ORPHA:79126)
- Hypertension (HP:0000822): The presence of chronic increased pressure in the systemic arterial system. Evidence: TAS. Frequency: Frequent (HP:0040282). (ORPHA:79126)
- Cyanosis (HP:0000961): Bluish discoloration of the skin and mucosa due to poor circulation or inadequate oxygenation of arterial or capillary blood. Evidence: TAS. Frequency: Frequent (HP:0040282). (ORPHA:79126)
- Fever (HP:0001945): Body temperature elevated above the normal range. Evidence: TAS. Frequency: Frequent (HP:0040282). (ORPHA:79126)
- Pleural effusion (HP:0002202): The presence of an excessive amount of fluid in the pleural cavity. Evidence: TAS. Frequency: Frequent (HP:0040282). (ORPHA:79126)
- Tachypnea (HP:0002789): Very rapid breathing. Evidence: TAS. Frequency: Frequent (HP:0040282). (ORPHA:79126)
- Fatigue (HP:0012378): A subjective feeling of tiredness characterized by a lack of energy and motivation. Evidence: TAS. Frequency: Frequent (HP:0040282). (ORPHA:79126)
- Crackles (HP:0030830): Crackles are discontinuous, explosive, and nonmusical adventitious lung sounds normally heard in inspiration and sometimes during expiration. Crackles are usually classified as fine and coarse crackles based on their duration, loudness, pitch, timing in the respiratory cycle, and relationship to coughing and changing body position. Evidence: TAS. Frequency: Frequent (HP:0040282). (ORPHA:79126)
- Nonproductive cough (HP:0031246): A cough that does not produce phlegm or mucus. Evidence: TAS. Frequency: Frequent (HP:0040282). (ORPHA:79126)
- Decreased DLCO (HP:0045051): Reduced ability of the lungs to transfer gas from inspired air to the bloodstream as measured by the diffusing capacity of the lungs for carbon monoxide (DLCO) test. Evidence: TAS. Frequency: Frequent (HP:0040282). (ORPHA:79126)
- Pericardial effusion (HP:0001698): Accumulation of fluid within the pericardium. Evidence: TAS. Frequency: Occasional (HP:0040283). (ORPHA:79126)
- Pulmonary fibrosis (HP:0002206): Replacement of normal lung tissues by fibroblasts and collagen. Evidence: TAS. Frequency: Occasional (HP:0040283). (ORPHA:79126)
- Lymphadenopathy (HP:0002716): Enlargement (swelling) of a lymph node. Evidence: TAS. Frequency: Occasional (HP:0040283). (ORPHA:79126)
- Arthralgia (HP:0002829): Joint pain. Evidence: TAS. Frequency: Occasional (HP:0040283). (ORPHA:79126)
- Elevated circulating creatinine concentration (HP:0003259): An increased amount of creatinine in the blood. Evidence: TAS. Frequency: Occasional (HP:0040283). (ORPHA:79126)
- Myalgia (HP:0003326): Pain in muscle. Evidence: TAS. Frequency: Occasional (HP:0040283). (ORPHA:79126)
- Elevated erythrocyte sedimentation rate (HP:0003565): An increased erythrocyte sedimentation rate (ESR). The ESR is a test that measures the distance that erythrocytes have fallen after one hour in a vertical column of anticoagulated blood under the influence of gravity. The ESR is a nonspecific finding. An elevation may indicate inflammation or may be caused by any condition that elevates fibrinogen. Evidence: TAS. Frequency: Occasional (HP:0040283). (ORPHA:79126)
- Elevated circulating C-reactive protein concentration (HP:0011227): The concentration of C-reactive protein in the blood circulation is above the upper limit of normal. Evidence: TAS. Frequency: Occasional (HP:0040283). (ORPHA:79126)
- Peripheral edema (HP:0012398): An abnormal accumulation of interstitial fluid in the soft tissues of the limbs. Evidence: TAS. Frequency: Occasional (HP:0040283). (ORPHA:79126)
- Subpleural honeycombing (HP:0031631): So-called honeycombs (variably sized cysts in a background of densely scarred tissue) located in the subpleural space. Evidence: TAS. Frequency: Occasional (HP:0040283). (ORPHA:79126)
- Reduced hematocrit (HP:0031851): A reduction below the normal ratio of the volume of red blood cells to the total volume of blood. Evidence: TAS. Frequency: Occasional (HP:0040283). (ORPHA:79126)
- Chest pain (HP:0100749): An unpleasant sensation characterized by physical discomfort (such as pricking, throbbing, or aching) localized to the chest. Evidence: TAS. Frequency: Occasional (HP:0040283). (ORPHA:79126)
- Atelectasis (HP:0100750): Collapse of part of a lung associated with absence of inflation (air) of that part. Evidence: TAS. Frequency: Occasional (HP:0040283). (ORPHA:79126)
These phenotypes are associated with the disease Acute interstitial pneumonia (ORPHA:79126).